Phenotypes associated with the disease schizophrenia 10 (OMIM:605419):
- Disturbance of facial expression (HP:0005324): An abnormality of the gestures or movements executed with the facial muscles with which emotions such as fear, joy, sadness, surprise, and disgust can be expressed. Evidence: IEA. (OMIM:605419)
- Mask-like facies (HP:0000298): A lack of facial expression often with staring eyes and a slightly open mouth. Evidence: IEA. (OMIM:605419)
- Schizophrenia (HP:0100753): A mental disorder characterized by a disintegration of thought processes and emotional responsiveness. It most commonly manifests as auditory hallucinations, paranoid or bizarre delusions, or disorganized speech and thinking. It is accompanied by significant social or occupational dysfunction. The onset of symptoms typically occurs in young adulthood, with a global lifetime prevalence of about 1%. This term is not a helpful parent term to describe abnormal experiences. Evidence: IEA. (OMIM:605419)
- Hallucinations (HP:0000738): Perceptions in a conscious and awake state that, in the absence of external stimuli, have qualities of real perception. These perceptions are vivid, substantial, and located in external objective space. Evidence: IEA. (OMIM:605419)
- Psychotic episodes (HP:0000725): Periods of time during which an individual experiences significant disturbances in their thoughts, perceptions, emotions, and behavior, resulting in a loss of touch with reality. These episodes are hallmark features of psychotic disorders such as schizophrenia, schizoaffective disorder, and certain forms of bipolar disorder. Evidence: IEA. (OMIM:605419)
- Delusion (HP:0000746): A delusion is a fixed false belief held despite evidence to the contrary. The term delusion broadly encompasses all false judgments that possess the following external characteristics to a significant, albeit unspecified, extent: (1) they are held with an exceptional level of conviction, accompanied by an unparalleled subjective certainty; (2) there is an inability to consider alternative experiences or compelling counter-arguments; (3) the content of the belief is impossible. Evidence: IEA. (OMIM:605419)
- Autosomal dominant inheritance (HP:0000006): A mode of inheritance that is observed for traits related to a gene encoded on one of the autosomes (i.e., the human chromosomes 1-22) in which a trait manifests in heterozygotes. In the context of medical genetics, an autosomal dominant disorder is caused when a single copy of the mutant allele is present. Males and females are affected equally, and can both transmit the disorder with a risk of 50% for each child of inheriting the mutant allele. Evidence: IEA. (OMIM:605419)